- Fever (HP:0001945): Body temperature elevated above the normal range. Evidence: TAS. Frequency: Very frequent (HP:0040281). (ORPHA:324625)
- Arthralgia (HP:0002829): Joint pain. Evidence: TAS. Frequency: Very frequent (HP:0040281). (ORPHA:324625)
- Fatigue (HP:0012378): A subjective feeling of tiredness characterized by a lack of energy and motivation. Evidence: TAS. Frequency: Very frequent (HP:0040281). (ORPHA:324625)
- Abnormal diminished volition (HP:0000745): A reduction in willful and motivated goal-directed behavior that is considered the determinant of behavior and adaptation that allows individuals to get started, be energized to perform a sustained and directed action. Evidence: TAS. Frequency: Frequent (HP:0040282). (ORPHA:324625)
- Skin rash (HP:0000988): A red eruption of the skin. Evidence: TAS. Frequency: Frequent (HP:0040282). (ORPHA:324625)
- Arthritis (HP:0001369): Inflammation of a joint. Evidence: TAS. Frequency: Frequent (HP:0040282). (ORPHA:324625)
- Joint swelling (HP:0001386). Evidence: TAS. Frequency: Frequent (HP:0040282). (ORPHA:324625)
- Joint stiffness (HP:0001387): Joint stiffness is a perceived sensation of tightness in a joint or joints when attempting to move them after a period of inactivity. Joint stiffness typically subsides over time. Evidence: TAS. Frequency: Frequent (HP:0040282). (ORPHA:324625)
- Headache (HP:0002315): Cephalgia, or pain sensed in various parts of the head, not confined to the area of distribution of any nerve. Evidence: TAS. Frequency: Frequent (HP:0040282). (ORPHA:324625)
- Myalgia (HP:0003326): Pain in muscle. Evidence: TAS. Frequency: Frequent (HP:0040282). (ORPHA:324625)
- Stiff interphalangeal joints (HP:0005198): Interphalangeal joint stiffness is a perceived sensation of tightness in the interphalangeal joints when attempting to move them after a period of inactivity. Evidence: TAS. Frequency: Frequent (HP:0040282). (ORPHA:324625)
- Depigmentation/hyperpigmentation of skin (HP:0007483). Evidence: TAS. Frequency: Frequent (HP:0040282). (ORPHA:324625)
- Pedal edema (HP:0010741): An abnormal accumulation of excess fluid in the lower extremity resulting in swelling of the feet and extending upward to the lower leg. Evidence: TAS. Frequency: Frequent (HP:0040282). (ORPHA:324625)
- Erythema (HP:0010783): Redness of the skin, caused by hyperemia of the capillaries in the lower layers of the skin. Evidence: TAS. Frequency: Frequent (HP:0040282). (ORPHA:324625)
- Macule (HP:0012733): A flat, distinct, discolored area of skin less than 1 cm wide that does not involve any change in the thickness or texture of the skin. Evidence: TAS. Frequency: Frequent (HP:0040282). (ORPHA:324625)
- Shoulder pain (HP:0030834): An unpleasant sensation characterized by physical discomfort (such as pricking, throbbing, or aching) localized to the shoulder. Evidence: TAS. Frequency: Frequent (HP:0040282). (ORPHA:324625)
- Knee pain (HP:0030839): An unpleasant sensation characterized by physical discomfort (such as pricking, throbbing, or aching) localized to the knee. Evidence: TAS. Frequency: Frequent (HP:0040282). (ORPHA:324625)
- Maculopapular exanthema (HP:0040186): A skin rash that is characterized by diffuse cutaneous erythema with areas of skin elevation. It may evolve to vesicles or papules as part of a more severe clinical entity. Different degrees of angioedema with involvement of subcutaneous tissue may also appear. Evidence: TAS. Frequency: Frequent (HP:0040282). (ORPHA:324625)
- Gingival bleeding (HP:0000225): Hemorrhage affecting the gingiva. Evidence: TAS. Frequency: Occasional (HP:0040283). (ORPHA:324625)
- Facial edema (HP:0000282). Evidence: TAS. Frequency: Occasional (HP:0040283). (ORPHA:324625)
- Epistaxis (HP:0000421): Epistaxis, or nosebleed, refers to a hemorrhage localized in the nose. Evidence: TAS. Frequency: Occasional (HP:0040283). (ORPHA:324625)
- Photophobia (HP:0000613): Excessive sensitivity to light with the sensation of discomfort or pain in the eyes due to exposure to bright light. Evidence: TAS. Frequency: Occasional (HP:0040283). (ORPHA:324625)
- Depression (HP:0000716): Frequently experiencing feelings of being down, miserable, and/or hopeless; struggling to recover from these moods; having a pessimistic outlook on the future; feeling a pervasive sense of shame; having a low self-worth; experiencing thoughts of suicide and engaging in suicidal behavior. Evidence: TAS. Frequency: Occasional (HP:0040283). (ORPHA:324625)
- Petechiae (HP:0000967): Petechiae are pinpoint-sized reddish/purple spots, resembling a rash, that appear just under the skin or a mucous membrane when capillaries have ruptured and some superficial bleeding into the skin has happened. This term refers to an abnormally increased susceptibility to developing petechiae. Evidence: TAS. Frequency: Occasional (HP:0040283). (ORPHA:324625)
- Pruritus (HP:0000989): Pruritus is an itch or a sensation that makes a person want to scratch. This term refers to an abnormally increased disposition to experience pruritus. Evidence: TAS. Frequency: Occasional (HP:0040283). (ORPHA:324625)
- Cutaneous photosensitivity (HP:0000992): An increased sensitivity of the skin to light. Photosensitivity may result in a rash upon exposure to the sun (which is known as photodermatosis). Photosensitivity can be diagnosed by phototests in which light is shone on small areas of skin. Evidence: TAS. Frequency: Occasional (HP:0040283). (ORPHA:324625)
- Abnormal bleeding (HP:0001892): An abnormal susceptibility to bleeding, often referred to as a bleeding diathesis. A bleeding diathesis may be related to vascular, platelet and coagulation defects. Evidence: TAS. Frequency: Occasional (HP:0040283). (ORPHA:324625)
- Vomiting (HP:0002013): Forceful ejection of the contents of the stomach through the mouth by means of a series of involuntary spasmic contractions. Evidence: TAS. Frequency: Occasional (HP:0040283). (ORPHA:324625)
- Diarrhea (HP:0002014): Abnormally increased frequency (usually defined as three or more) loose or watery bowel movements a day. Evidence: TAS. Frequency: Occasional (HP:0040283). (ORPHA:324625)
- Crusting erythematous dermatitis (HP:0007473). Evidence: TAS. Frequency: Occasional (HP:0040283). (ORPHA:324625)
- Abnormal blistering of the skin (HP:0008066): The presence of one or more bullae on the skin, defined as fluid-filled blisters more than 5 mm in diameter with thin walls. Evidence: TAS. Frequency: Occasional (HP:0040283). (ORPHA:324625)
- Peripheral neuropathy (HP:0009830): Peripheral neuropathy is a general term for any disorder of the peripheral nervous system. The main clinical features used to classify peripheral neuropathy are distribution, type (mainly demyelinating versus mainly axonal), duration, and course. Evidence: TAS. Frequency: Occasional (HP:0040283). (ORPHA:324625)
- Erythema nodosum (HP:0012219): An erythematous eruption commonly associated with drug reactions or infection and characterized by inflammatory nodules that are usually tender, multiple, and bilateral. Evidence: TAS. Frequency: Occasional (HP:0040283). (ORPHA:324625)
- Chills (HP:0025143): A sudden sensation of feeling cold. Evidence: TAS. Frequency: Occasional (HP:0040283). (ORPHA:324625)
- Bursitis (HP:0025232): Inflammation of a synovial bursa. Evidence: TAS. Frequency: Occasional (HP:0040283). (ORPHA:324625)
- Cervical lymphadenopathy (HP:0025289): Enlarged lymph nodes in the neck. Evidence: TAS. Frequency: Occasional (HP:0040283). (ORPHA:324625)
- Red eye (HP:0025337): A reddish appearance over the white part (sclera) of the eye ranging from a few enlarged blood vessels appearing as wiggly lines over the sclera to a bright red color completely covering to sclera. Evidence: TAS. Frequency: Occasional (HP:0040283). (ORPHA:324625)
- Ankle joint effusion (HP:0032063): Abnormal accumulation of fluid in or around the ankle joint. Evidence: TAS. Frequency: Occasional (HP:0040283). (ORPHA:324625)
- Periostitis (HP:0040165): Inflammation of the periosteum. Evidence: TAS. Frequency: Occasional (HP:0040283). (ORPHA:324625)
- Enthesitis (HP:0100686). Evidence: TAS. Frequency: Occasional (HP:0040283). (ORPHA:324625)
- Synovitis (HP:0100769). Evidence: TAS. Frequency: Occasional (HP:0040283). (ORPHA:324625)
- Skin vesicle (HP:0200037): A circumscribed, fluid-containing, epidermal elevation less than 10mm in diameter at the widest point that (i) Contain serous exudates or serum mixed with blood or pus; (ii) Are discrete, grouped, irregularly distributed, or linear as in Rhus dermatitis; (iii) Are short-lived. Vesicles may break spontaneously or evolve into bullae by enlarging or coalescing with other vesicles. Evidence: TAS. Frequency: Occasional (HP:0040283). (ORPHA:324625)
- Seizure (HP:0001250): A seizure is an intermittent abnormality of nervous system physiology characterized by a transient occurrence of signs and/or symptoms due to abnormal excessive or synchronous neuronal activity in the brain. Evidence: TAS. Frequency: Very rare (HP:0040284). (ORPHA:324625)
- Infectious encephalitis (HP:0002383): A disorder of the brain caused by an infectious agent that presents with fever, headache, and an altered level of consciousness. There may also be focal or multifocal neurologic deficits, and focal or generalized seizure activity. Evidence: TAS. Frequency: Very rare (HP:0040284). (ORPHA:324625)
- Lymphadenopathy (HP:0002716): Enlargement (swelling) of a lymph node. Evidence: TAS. Frequency: Very rare (HP:0040284). (ORPHA:324625)
- Osteolysis (HP:0002797): Osteolysis refers to the destruction of bone through bone resorption with removal or loss of calcium. Evidence: TAS. Frequency: Very rare (HP:0040284). (ORPHA:324625)
- Paresthesia (HP:0003401): Abnormal sensations such as tingling, pricking, or numbness of the skin with no apparent physical cause. Evidence: TAS. Frequency: Very rare (HP:0040284). (ORPHA:324625)
- Peripheral nerve compression (HP:0003406). Evidence: TAS. Frequency: Very rare (HP:0040284). (ORPHA:324625)
- Constrictive median neuropathy (HP:0012185): Injury to the median nerve caused by its entrapment at the wrist as it traverses through the carpal tunnel. Clinically, constrictive median neuropathy is characterized by pain, paresthesia, and weakness in the median nerve distribution of the hand. Evidence: TAS. Frequency: Very rare (HP:0040284). (ORPHA:324625)
- Raynaud phenomenon (HP:0030880). Evidence: TAS. Frequency: Very rare (HP:0040284). (ORPHA:324625)
- Neuritis (HP:0031002): Inflammation of a nerve. Evidence: TAS. Frequency: Very rare (HP:0040284). (ORPHA:324625)
These phenotypes are associated with the disease Chikungunya (ORPHA:324625).